Phenotypes associated with the disease 6p22 microdeletion syndrome (ORPHA:251046):
- Abnormality of the genital system (HP:0000078): An abnormality of the genital system. Evidence: TAS. Frequency: Occasional (HP:0040283). (ORPHA:251046)
- Hydronephrosis (HP:0000126): Severe distention of the kidney with dilation of the renal pelvis and calices. Evidence: TAS. Frequency: Frequent (HP:0040282). (ORPHA:251046)
- Abnormal palate morphology (HP:0000174): Any abnormality of the palate, i.e., of roof of the mouth. Evidence: TAS. Frequency: Occasional (HP:0040283). (ORPHA:251046)
- Hydrocephalus (HP:0000238): Hydrocephalus is an active distension of the ventricular system of the brain resulting from inadequate passage of CSF from its point of production within the cerebral ventricles to its point of absorption into the systemic circulation. Evidence: TAS. Frequency: Frequent (HP:0040282). (ORPHA:251046)
- Epicanthus (HP:0000286): A fold of skin starting above the medial aspect of the upper eyelid and arching downward to cover, pass in front of and lateral to the medial canthus. Evidence: TAS. Frequency: Frequent (HP:0040282). (ORPHA:251046)
- Hearing impairment (HP:0000365): A decreased magnitude of the sensory perception of sound. Evidence: TAS. Frequency: Occasional (HP:0040283). (ORPHA:251046)
- Low-set ears (HP:0000369): Upper insertion of the ear to the scalp below an imaginary horizontal line drawn between the inner canthi of the eye and extending posteriorly to the ear. Evidence: TAS. Frequency: Frequent (HP:0040282). (ORPHA:251046)
- Overfolded helix (HP:0000396): A condition in which the helix is folded over to a greater degree than normal. That is, excessive curling of the helix edge, whereby the free edge is parallel to the plane of the ear. Evidence: TAS. Frequency: Frequent (HP:0040282). (ORPHA:251046)
- Short neck (HP:0000470): Diminished length of the neck. Evidence: TAS. Frequency: Frequent (HP:0040282). (ORPHA:251046)
- Strabismus (HP:0000486): A misalignment of the eyes so that the visual axes deviate from bifoveal fixation. The classification of strabismus may be based on a number of features including the relative position of the eyes, whether the deviation is latent or manifest, intermittent or constant, concomitant or otherwise and according to the age of onset and the relevance of any associated refractive error. Evidence: TAS. Frequency: Frequent (HP:0040282). (ORPHA:251046)
- Deeply set eye (HP:0000490): An eye that is more deeply recessed into the plane of the face than is typical. Evidence: TAS. Frequency: Frequent (HP:0040282). (ORPHA:251046)
- Hypotelorism (HP:0000601): Interpupillary distance less than 2 SD below the mean (alternatively, the appearance of an decreased interpupillary distance or closely spaced eyes). Evidence: TAS. Frequency: Occasional (HP:0040283). (ORPHA:251046)
- Abnormal skull morphology (HP:0000929): An abnormality of the skull, the bony framework of the head which is comprised of the neurocranium (with eight cranial bones) and the viscerocranium (facial skeleton) that comprises fourteen facial bones with the mandible as its largest bone. Evidence: TAS. Frequency: Very frequent (HP:0040281). (ORPHA:251046)
- Hypotonia (HP:0001252): Hypotonia is an abnormally low muscle tone (the amount of tension or resistance to movement in a muscle). Even when relaxed, muscles have a continuous and passive partial contraction which provides some resistance to passive stretching. Hypotonia thus manifests as diminished resistance to passive stretching. Hypotonia is not the same as muscle weakness, although the two conditions can co-exist. Evidence: TAS. Frequency: Very frequent (HP:0040281). (ORPHA:251046)
- Mild intellectual disability (HP:0001256): Mild intellectual disability (ID) is defined as a type of ID characterized by mildly sub-average adaptive functioning and intellectual functioning, with an intelligence quotient (IQ) the range of 50-69. Evidence: TAS. Frequency: Very frequent (HP:0040281). (ORPHA:251046)
- Redundant skin (HP:0001582): Loose and sagging skin often associated with loss of skin elasticity. Evidence: TAS. Frequency: Occasional (HP:0040283). (ORPHA:251046)
- Patent ductus arteriosus (HP:0001643): In utero, the ductus arteriosus (DA) serves to divert ventricular output away from the lungs and toward the placenta by connecting the main pulmonary artery to the descending aorta. A patent ductus arteriosus (PDA) in the first 3 days of life is a physiologic shunt in healthy term and preterm newborn infants, and normally is substantially closed within about 24 hours after bith and completely closed after about three weeks. Failure of physiologcal closure is referred to a persistent or patent ductus arteriosus (PDA). Depending on the degree of left-to-right shunting, PDA can have clinical consequences. Evidence: TAS. Frequency: Frequent (HP:0040282). (ORPHA:251046)
- Finger syndactyly (HP:0006101): Webbing or fusion of the fingers, involving soft parts only or including bone structure. Bony fusions are referred to as "bony" Syndactyly if the fusion occurs in a radio-ulnar axis. Fusions of bones of the fingers in a proximo-distal axis are referred to as "Symphalangism". Evidence: TAS. Frequency: Frequent (HP:0040282). (ORPHA:251046)
- Abnormal nervous system morphology (HP:0012639): A structural anomaly of the nervous system. Evidence: TAS. Frequency: Frequent (HP:0040282). (ORPHA:251046)
- Clinodactyly (HP:0030084): An angulation of a digit at an interphalangeal joint in the plane of the palm (finger) or sole (toe). Evidence: TAS. Frequency: Frequent (HP:0040282). (ORPHA:251046)
- Hernia (HP:0100790). Evidence: TAS. Frequency: Frequent (HP:0040282). (ORPHA:251046)